- Intellectual disability (HP:0001249): The term intellectual disability or intellectual developmental disorder is used to describe significantly sub-average intellectual and adaptive functioning based on clinical assessment and as measured by individually administered, appropriately normed, standardized and validated tests of intellectual functioning and adaptive behavior, with onset during the developmental period from infancy through adolescence. Evidence: TAS. Frequency: Obligate (HP:0040280). (ORPHA:313892)
- Motor delay (HP:0001270): A type of Developmental delay characterized by a delay in acquiring motor skills. Evidence: TAS. Frequency: Obligate (HP:0040280). (ORPHA:313892)
- Delayed speech and language development (HP:0000750): A degree of language development that is significantly below the norm for a child of a specified age. Evidence: TAS. Frequency: Very frequent (HP:0040281). (ORPHA:313892)
- Hyperplasia of the maxilla (HP:0430028): Abnormally increased dimension of the maxilla, especially relative to the mandible, resulting in a malocclusion or malalignment between the upper and lower teeth or in anterior positioning of the nasal base, increased convexity of the face, increased nasolabial angle, or increased width (transverse dimension of the maxilla. Evidence: TAS. Frequency: Very frequent (HP:0040281). (ORPHA:313892)
- Narrow palate (HP:0000189): Width of the palate more than 2 SD below the mean (objective) or apparently decreased palatal width (subjective). Evidence: TAS. Frequency: Frequent (HP:0040282). (ORPHA:313892)
- Strabismus (HP:0000486): A misalignment of the eyes so that the visual axes deviate from bifoveal fixation. The classification of strabismus may be based on a number of features including the relative position of the eyes, whether the deviation is latent or manifest, intermittent or constant, concomitant or otherwise and according to the age of onset and the relevance of any associated refractive error. Evidence: TAS. Frequency: Frequent (HP:0040282). (ORPHA:313892)
- Myopia (HP:0000545): An abnormality of refraction characterized by the ability to see objects nearby clearly, while objects in the distance appear blurry. Evidence: TAS. Frequency: Frequent (HP:0040282). (ORPHA:313892)
- Exotropia (HP:0000577): A form of strabismus with one or both eyes deviated outward. Evidence: TAS. Frequency: Frequent (HP:0040282). (ORPHA:313892)
- Optic atrophy (HP:0000648): Atrophy of the optic nerve. Optic atrophy results from the death of the retinal ganglion cell axons that comprise the optic nerve and manifesting as a pale optic nerve on fundoscopy. Evidence: TAS. Frequency: Frequent (HP:0040282). (ORPHA:313892)
- Dental crowding (HP:0000678): Changes in alignment of teeth in the dental arch. Evidence: TAS. Frequency: Frequent (HP:0040282). (ORPHA:313892)
- Anxiety (HP:0000739): Intense feelings of nervousness, tension, or panic often arise in response to interpersonal stresses. There is worry about the negative effects of past unpleasant experiences and future negative possibilities. Individuals may feel fearful, apprehensive, or threatened by uncertainty, and they may also have fears of falling apart or losing control. Evidence: TAS. Frequency: Frequent (HP:0040282). (ORPHA:313892)
- Pectus carinatum (HP:0000768): A deformity of the chest caused by overgrowth of the ribs and characterized by protrusion of the sternum. Evidence: TAS. Frequency: Frequent (HP:0040282). (ORPHA:313892)
- Hypotonia (HP:0001252): Hypotonia is an abnormally low muscle tone (the amount of tension or resistance to movement in a muscle). Even when relaxed, muscles have a continuous and passive partial contraction which provides some resistance to passive stretching. Hypotonia thus manifests as diminished resistance to passive stretching. Hypotonia is not the same as muscle weakness, although the two conditions can co-exist. Evidence: TAS. Frequency: Frequent (HP:0040282). (ORPHA:313892)
- Frontal bossing (HP:0002007): Bilateral bulging of the lateral frontal bone prominences with relative sparing of the midline. Evidence: TAS. Frequency: Frequent (HP:0040282). (ORPHA:313892)
- Exaggerated median tongue furrow (HP:0002711): Increased depth of the median tongue furrow. Evidence: TAS. Frequency: Frequent (HP:0040282). (ORPHA:313892)
- Lumbar hyperlordosis (HP:0002938): An abnormal accentuation of the inward curvature of the spine in the lumbar region. Evidence: TAS. Frequency: Frequent (HP:0040282). (ORPHA:313892)
- Vertebral fusion (HP:0002948): A developmental defect leading to the union of two adjacent vertebrae. Evidence: TAS. Frequency: Frequent (HP:0040282). (ORPHA:313892)
- 2-3 toe syndactyly (HP:0004691): Syndactyly with fusion of toes two and three. Evidence: TAS. Frequency: Frequent (HP:0040282). (ORPHA:313892)
- Thoracic kyphoscoliosis (HP:0005659). Evidence: TAS. Frequency: Frequent (HP:0040282). (ORPHA:313892)
- Abnormal brain morphology (HP:0012443): A structural abnormality of the brain, which has as its parts the forebrain, midbrain, and hindbrain. Evidence: TAS. Frequency: Frequent (HP:0040282). (ORPHA:313892)
- Abnormality of the genital system (HP:0000078): An abnormality of the genital system. Evidence: TAS. Frequency: Occasional (HP:0040283). (ORPHA:313892)
- Aggressive behavior (HP:0000718): Behavior or an act aimed at harming a person, animal, or physical property (e.g., acts of physical violence; shouting, swearing, and using harsh language; slashing someone's tires). Evidence: TAS. Frequency: Occasional (HP:0040283). (ORPHA:313892)
- Motor stereotypy (HP:0000733): Use of the same abnormal action in response to certain triggers or at random. They may be used as a way to regulate one's internal state but must otherwise have no apparent functional purpose. Evidence: TAS. Frequency: Occasional (HP:0040283). (ORPHA:313892)
- Seizure (HP:0001250): A seizure is an intermittent abnormality of nervous system physiology characterized by a transient occurrence of signs and/or symptoms due to abnormal excessive or synchronous neuronal activity in the brain. Evidence: TAS. Frequency: Occasional (HP:0040283). (ORPHA:313892)
- Mitral regurgitation (HP:0001653): An abnormality of the mitral valve characterized by insufficiency or incompetence of the mitral valve resulting in retrograde leaking of blood through the mitral valve upon ventricular contraction. Evidence: TAS. Frequency: Occasional (HP:0040283). (ORPHA:313892)
- Gastroesophageal reflux (HP:0002020): A condition in which the stomach contents leak backwards from the stomach into the esophagus through the lower esophageal sphincter. Evidence: TAS. Frequency: Occasional (HP:0040283). (ORPHA:313892)
- Scoliosis (HP:0002650): The presence of an abnormal lateral curvature of the spine. Evidence: TAS. Frequency: Occasional (HP:0040283). (ORPHA:313892)
- Butterfly vertebrae (HP:0003316): A butterfly vertebra (sagittal cleft vertebra or anterior rachischisis) is a sagittal defect in the vertebral body caused by failure of fusion of the two lateral chondrification centers during embryogenesis. The name is based on the appearance of the two hemivertebrae emerging as butterfly wings from the central cleft on x-ray. Evidence: TAS. Frequency: Occasional (HP:0040283). (ORPHA:313892)
- Attention deficit hyperactivity disorder (HP:0007018): Attention deficit hyperactivity disorder (ADHD) manifests at age 2-3 years or by first grade at the latest. The main symptoms are distractibility, impulsivity, hyperactivity, and often trouble organizing tasks and projects, difficulty going to sleep, and social problems from being aggressive, loud, or impatient. Evidence: TAS. Frequency: Occasional (HP:0040283). (ORPHA:313892)
- Feeding difficulties (HP:0011968): Impaired ability to eat related to problems gathering food and getting ready to suck, chew, or swallow it. Evidence: TAS. Frequency: Occasional (HP:0040283). (ORPHA:313892)
- Self-injurious behavior (HP:0100716): Self-aggression. Evidence: TAS. Frequency: Occasional (HP:0040283). (ORPHA:313892)
These phenotypes are associated with the disease Developmental and speech delay due to SOX5 deficiency (ORPHA:313892).